- Pes cavus (HP:0001761, a Human Phenotype Ontology term): An increase in height of the medial longitudinal arch of the foot that does not flatten on weight bearing (i.e., a distinctly hollow form of the sole of the foot when it is bearing weight). Evidence: IEA. (OMIM:212850)
- Sensorineural hearing impairment (HP:0000407, a Human Phenotype Ontology term): A type of hearing impairment in one or both ears related to an abnormal functionality of the cochlear nerve. Evidence: IEA. (OMIM:212850)
- Ataxia (HP:0001251, a Human Phenotype Ontology term): Ataxia refers to impaired coordination of voluntary muscle movement. Cerebellar ataxia refers to ataxia due to dysfunction of the cerebellum. This causes a variety of elementary neurological deficits including asynergy (lack of coordination between muscles, limbs and joints), dysmetria (lack of ability to judge distances that can lead to under- or overshoot in grasping movements), and dysdiadochokinesia (inability to perform rapid movements requiring antagonizing muscle groups to be switched on and off repeatedly). Evidence: IEA. Onset: Adult onset (HP:0003581, a Human Phenotype Ontology term). (OMIM:212850)
- Autosomal recessive inheritance (HP:0000007, a Human Phenotype Ontology term): A mode of inheritance that is observed for traits related to a gene encoded on one of the autosomes (i.e., the human chromosomes 1-22) in which a trait manifests in individuals with two pathogenic alleles, either homozygotes (two copies of the same mutant allele) or compound heterozygotes (whereby each copy of a gene has a distinct mutant allele). Evidence: IEA. (OMIM:212850)
These phenotypes are associated with the disease cerebellar ataxia and neurosensory deafness (OMIM:212850, an entry in Online Mendelian Inheritance in Man).